Phenotypes associated with the disease Secondary short bowel syndrome (ORPHA:95427):
- Weight loss (HP:0001824): Reduction of total body weight. Evidence: TAS. Frequency: Frequent (HP:0040282). (ORPHA:95427)
- Malabsorption (HP:0002024): Impaired ability to absorb one or more nutrients from the intestine. Evidence: TAS. Frequency: Frequent (HP:0040282). (ORPHA:95427)
- Abnormal small intestine morphology (HP:0002244): A structural abnormality of the small intestine. Evidence: TAS. Frequency: Frequent (HP:0040282). (ORPHA:95427)
- Malnutrition (HP:0004395): A deficiency in the intake of energy and nutrients. Evidence: TAS. Frequency: Frequent (HP:0040282). (ORPHA:95427)
- Abnormality of vitamin metabolism (HP:0100508): An anomaly in the metabolism of a vitamin. Evidence: TAS. Frequency: Frequent (HP:0040282). (ORPHA:95427)
- Primary hypothyroidism (HP:0000832): A type of hypothyroidism that results from a defect in the thyroid gland. Evidence: TAS. Frequency: Occasional (HP:0040283). (ORPHA:95427)
- Cholestasis (HP:0001396): Impairment of bile flow due to obstruction in bile ducts. Evidence: TAS. Frequency: Occasional (HP:0040283). (ORPHA:95427)
- Failure to thrive (HP:0001508): Failure to thrive (FTT) refers to a child whose physical growth is substantially below the norm. Evidence: TAS. Frequency: Occasional (HP:0040283). (ORPHA:95427)
- Growth delay (HP:0001510): A deficiency or slowing down of growth pre- and postnatally. Evidence: TAS. Frequency: Occasional (HP:0040283). (ORPHA:95427)
- Gastroschisis (HP:0001543): A type of congenital ventral incomplete closure of the abdominal wall in which the intestines and sometimes other organs extend freely into the amniotic fluid space through a small opening in the abdomen, usually to the right of the umbilicus. Evidence: TAS. Frequency: Occasional (HP:0040283). (ORPHA:95427)
- Dehydration (HP:0001944). Evidence: TAS. Frequency: Occasional (HP:0040283). (ORPHA:95427)
- Abnormal thrombosis (HP:0001977): Venous or arterial thrombosis (formation of blood clots) of spontaneous nature and which cannot be fully explained by acquired risk (e.g. atherosclerosis). Evidence: TAS. Frequency: Occasional (HP:0040283). (ORPHA:95427)
- Vomiting (HP:0002013): Forceful ejection of the contents of the stomach through the mouth by means of a series of involuntary spasmic contractions. Evidence: TAS. Frequency: Occasional (HP:0040283). (ORPHA:95427)
- Diarrhea (HP:0002014): Abnormally increased frequency (usually defined as three or more) loose or watery bowel movements a day. Evidence: TAS. Frequency: Occasional (HP:0040283). (ORPHA:95427)
- Constipation (HP:0002019): Infrequent or difficult evacuation of feces. Evidence: TAS. Frequency: Occasional (HP:0040283). (ORPHA:95427)
- Steatorrhea (HP:0002570): Greater than normal amounts of fat in the feces. This is a result of malabsorption of lipids in the small intestine and results in frothy foul-smelling fecal matter that floats. Evidence: TAS. Frequency: Occasional (HP:0040283). (ORPHA:95427)
- Volvulus (HP:0002580): Abnormal twisting of a portion of intestine around itself or around a stalk of mesentery tissue. Evidence: TAS. Frequency: Occasional (HP:0040283). (ORPHA:95427)
- Polyphagia (HP:0002591): A neurological anomaly with gross overeating associated with an abnormally strong desire or need to eat. Evidence: TAS. Frequency: Occasional (HP:0040283). (ORPHA:95427)
- Atherosclerosis (HP:0002621): A condition characterized by patchy atheromas or atherosclerotic plaques which develop in the walls of medium-sized and large arteries and can lead to arterial stenosis with reduced or blocked blood flow. Evidence: TAS. Frequency: Occasional (HP:0040283). (ORPHA:95427)
- Abnormal circulating electrolyte concentration (HP:0003111): Abnormality of the homeostasis (concentration) of a monoatomic ion. Evidence: TAS. Frequency: Occasional (HP:0040283). (ORPHA:95427)
- Abdominal distention (HP:0003270): Distention of the abdomen. Evidence: TAS. Frequency: Occasional (HP:0040283). (ORPHA:95427)
- Low plasma citrulline (HP:0003572): A decreased concentration of citrulline in the blood. Evidence: TAS. Frequency: Occasional (HP:0040283). (ORPHA:95427)
- Enterocolitis (HP:0004387): An inflammation of the colon and small intestine. However, most conditions are either categorized as Enteritis (inflammation of the small intestine) or Colitis (inflammation of the large intestine). Evidence: TAS. Frequency: Occasional (HP:0040283). (ORPHA:95427)
- Villous atrophy (HP:0011473): The enteric villi are atrophic or absent. Evidence: TAS. Frequency: Occasional (HP:0040283). (ORPHA:95427)
- Small intestinal dysmotility (HP:0012850): Abnormal small intestinal contractions, such as spasms and intestinal paralysis related to the loss of the ability of the gut to coordinate muscular activity because of endogenous or exogenous causes. Evidence: TAS. Frequency: Occasional (HP:0040283). (ORPHA:95427)
- Splanchnic vein thrombosis (HP:0030247): The term splanchnic vein thrombosis encompasses Budd-Chiari syndrome (hepatic vein thrombosis), extrahepatic portal vein obstruction (EHPVO), and mesenteric vein thrombosis; the word splanchnic is used to refer to the visceral organs (of the abdominal cavity). Evidence: TAS. Frequency: Occasional (HP:0040283). (ORPHA:95427)
- Mesenteric venous thrombosis (HP:0030248): A clot that obstructs blood flow in a mesenteric vein (the superior and the inferior mesenteric vein drain blood from the small and large intestine). Evidence: TAS. Frequency: Occasional (HP:0040283). (ORPHA:95427)
- Hyporeflexia (HP:0001265): Reduction of neurologic reflexes such as the knee-jerk reaction. Evidence: TAS. Frequency: Very rare (HP:0040284). (ORPHA:95427)
- Aganglionic megacolon (HP:0002251): An abnormality resulting from a lack of intestinal ganglion cells (i.e., an aganglionic section of bowel) that results in bowel obstruction with enlargement of the colon. Evidence: TAS. Frequency: Very rare (HP:0040284). (ORPHA:95427)
- Intestinal atresia (HP:0011100): An abnormal closure, or atresia of the tubular structure of the intestine. Evidence: TAS. Frequency: Very rare (HP:0040284). (ORPHA:95427)
- Central hypothyroidism (HP:0011787): A type of hypothyroidism due to an insufficient stimulation of an otherwise normal thyroid gland. Central hypothyroidism is caused by either pituitary (secondary hypothyroidism) or hypothalamic (tertiary hypothyroidism) defects. Evidence: TAS. Frequency: Very rare (HP:0040284). (ORPHA:95427)
- Sepsis (HP:0100806): Sepsis is defined as life-threatening organ dysfunction caused by a dysregulated host response to infection. Evidence: TAS. Frequency: Very rare (HP:0040284). (ORPHA:95427)